Phenotypes associated with the disease pancreatic cancer, susceptibility to, 2 (OMIM:613347):
- Neoplasm of the pancreas (HP:0002894): A tumor (abnormal growth of tissue) of the pancreas. Evidence: TAS. (OMIM:613347)